- Moderate intellectual disability (HP:0002342): Moderate intellectual disability (ID) is defined as a type of ID characterized by moderately sub-average adaptive functioning and intellectual functioning, with an intelligence quotient (IQ) the range of 35-49. Evidence: TAS. Frequency: Very frequent (HP:0040281). (ORPHA:96061)
- Vesicoureteral reflux (HP:0000076): Abnormal (retrograde) movement of urine from the bladder into ureters or kidneys related to inadequacy of the valvular mechanism at the ureterovesicular junction or other causes. Evidence: TAS. Frequency: Frequent (HP:0040282). (ORPHA:96061)
- Hydronephrosis (HP:0000126): Severe distention of the kidney with dilation of the renal pelvis and calices. Evidence: TAS. Frequency: Frequent (HP:0040282). (ORPHA:96061)
- Dolichocephaly (HP:0000268): An abnormality of skull shape characterized by a increased anterior-posterior diameter, i.e., an increased antero-posterior dimension of the skull. Cephalic index less than 76%. Alternatively, an apparently increased antero-posterior length of the head compared to width. Often due to premature closure of the sagittal suture. Evidence: TAS. Frequency: Frequent (HP:0040282). (ORPHA:96061)
- Long face (HP:0000276): Facial height (length) is more than 2 standard deviations above the mean (objective); or, an apparent increase in the height (length) of the face (subjective). Evidence: TAS. Frequency: Frequent (HP:0040282). (ORPHA:96061)
- Hypertelorism (HP:0000316): Interpupillary distance more than 2 SD above the mean (alternatively, the appearance of an increased interpupillary distance or widely spaced eyes). Evidence: TAS. Frequency: Frequent (HP:0040282). (ORPHA:96061)
- Micrognathia (HP:0000347): Developmental hypoplasia of the mandible. Evidence: TAS. Frequency: Frequent (HP:0040282). (ORPHA:96061)
- Abnormal pinna morphology (HP:0000377): An abnormality of the pinna, which is also referred to as the auricle or external ear. Evidence: TAS. Frequency: Frequent (HP:0040282). (ORPHA:96061)
- Macrotia (HP:0000400): Median longitudinal ear length greater than two standard deviations above the mean and median ear width greater than two standard deviations above the mean (objective); or, apparent increase in length and width of the pinna (subjective). Evidence: TAS. Frequency: Frequent (HP:0040282). (ORPHA:96061)
- Protruding ear (HP:0000411): Angle formed by the plane of the ear and the mastoid bone greater than the 97th centile for age (objective); or, outer edge of the helix more than 2 cm from the mastoid at the point of maximum distance (objective). Evidence: TAS. Frequency: Frequent (HP:0040282). (ORPHA:96061)
- Wide nose (HP:0000445): Interalar distance more than two standard deviations above the mean for age, i.e., an apparently increased width of the nasal base and alae. Evidence: TAS. Frequency: Frequent (HP:0040282). (ORPHA:96061)
- Broad nasal tip (HP:0000455): Increase in width of the nasal tip. Evidence: TAS. Frequency: Frequent (HP:0040282). (ORPHA:96061)
- Anteverted nares (HP:0000463): Anteriorly-facing nostrils viewed with the head in the Frankfurt horizontal and the eyes of the observer level with the eyes of the subject. This gives the appearance of an upturned nose (upturned nasal tip). Evidence: TAS. Frequency: Frequent (HP:0040282). (ORPHA:96061)
- Strabismus (HP:0000486): A misalignment of the eyes so that the visual axes deviate from bifoveal fixation. The classification of strabismus may be based on a number of features including the relative position of the eyes, whether the deviation is latent or manifest, intermittent or constant, concomitant or otherwise and according to the age of onset and the relevance of any associated refractive error. Evidence: TAS. Frequency: Frequent (HP:0040282). (ORPHA:96061)
- Deeply set eye (HP:0000490): An eye that is more deeply recessed into the plane of the face than is typical. Evidence: TAS. Frequency: Frequent (HP:0040282). (ORPHA:96061)
- Abnormal rib morphology (HP:0000772): An anomaly of the rib. Evidence: TAS. Frequency: Frequent (HP:0040282). (ORPHA:96061)
- Narrow chest (HP:0000774): Reduced width of the chest from side to side, associated with a reduced distance from the sternal notch to the tip of the shoulder. Evidence: TAS. Frequency: Frequent (HP:0040282). (ORPHA:96061)
- Limitation of joint mobility (HP:0001376): A reduction in the freedom of movement of one or more joints. Evidence: TAS. Frequency: Frequent (HP:0040282). (ORPHA:96061)
- Deep plantar creases (HP:0001869): The presence of unusually deep creases (ridges/wrinkles) on the skin of sole of foot. Evidence: TAS. Frequency: Frequent (HP:0040282). (ORPHA:96061)
- Frontal bossing (HP:0002007): Bilateral bulging of the lateral frontal bone prominences with relative sparing of the midline. Evidence: TAS. Frequency: Frequent (HP:0040282). (ORPHA:96061)
- Scoliosis (HP:0002650): The presence of an abnormal lateral curvature of the spine. Evidence: TAS. Frequency: Frequent (HP:0040282). (ORPHA:96061)
- Narrow pelvis bone (HP:0003275): Reduced side to side width of the pelvis. Evidence: TAS. Frequency: Frequent (HP:0040282). (ORPHA:96061)
- Vertebral segmentation defect (HP:0003422): An abnormality related to a defect of vertebral separation during development. Evidence: TAS. Frequency: Frequent (HP:0040282). (ORPHA:96061)
- Deep palmar crease (HP:0006191): Excessively deep creases of the palm. Evidence: TAS. Frequency: Frequent (HP:0040282). (ORPHA:96061)
- Patellar aplasia (HP:0006443): Absence of the patella. Evidence: TAS. Frequency: Frequent (HP:0040282). (ORPHA:96061)
- Corneal opacity (HP:0007957): A reduction of corneal clarity. Evidence: TAS. Frequency: Frequent (HP:0040282). (ORPHA:96061)
- Abnormal antihelix morphology (HP:0009738): An abnormality of the antihelix. Evidence: TAS. Frequency: Frequent (HP:0040282). (ORPHA:96061)
- Camptodactyly of finger (HP:0100490): The distal interphalangeal joint and/or the proximal interphalangeal joint of the fingers cannot be extended to 180 degrees by either active or passive extension. Evidence: TAS. Frequency: Frequent (HP:0040282). (ORPHA:96061)
- Cryptorchidism (HP:0000028): Testis in inguinal canal. That is, absence of one or both testes from the scrotum owing to failure of the testis or testes to descend through the inguinal canal to the scrotum. Evidence: TAS. Frequency: Occasional (HP:0040283). (ORPHA:96061)
- Tall stature (HP:0000098): A height above that which is expected according to age and gender norms. Evidence: TAS. Frequency: Occasional (HP:0040283). (ORPHA:96061)
- Cleft palate (HP:0000175): Cleft palate is a developmental defect of the palate resulting from a failure of fusion of the palatine processes and manifesting as a separation of the roof of the mouth (soft and hard palate). Evidence: TAS. Frequency: Occasional (HP:0040283). (ORPHA:96061)
- High palate (HP:0000218): Height of the palate more than 2 SD above the mean (objective) or palatal height at the level of the first permanent molar more than twice the height of the teeth (subjective). Evidence: TAS. Frequency: Occasional (HP:0040283). (ORPHA:96061)
- Hearing impairment (HP:0000365): A decreased magnitude of the sensory perception of sound. Evidence: TAS. Frequency: Occasional (HP:0040283). (ORPHA:96061)
- Short neck (HP:0000470): Diminished length of the neck. Evidence: TAS. Frequency: Occasional (HP:0040283). (ORPHA:96061)
- Hypopigmentation of the skin (HP:0001010): A reduction of skin color related to a decrease in melanin production and deposition. Evidence: TAS. Frequency: Occasional (HP:0040283). (ORPHA:96061)
- Hypopigmented skin patches (HP:0001053). Evidence: TAS. Frequency: Occasional (HP:0040283). (ORPHA:96061)
- Agenesis of corpus callosum (HP:0001274): Absence of the corpus callosum as a result of the failure of the corpus callosum to develop, which can be the result of a failure in any one of the multiple steps of callosal development including cellular proliferation and migration, axonal growth or glial patterning at the midline. Evidence: TAS. Frequency: Occasional (HP:0040283). (ORPHA:96061)
- Arthrogryposis multiplex congenita (HP:0002804): Multiple congenital contractures in different body areas. Evidence: TAS. Frequency: Occasional (HP:0040283). (ORPHA:96061)
- Clinodactyly of the 5th finger (HP:0004209): Clinodactyly refers to a bending or curvature of the fifth finger in the radial direction (i.e., towards the 4th finger). Evidence: TAS. Frequency: Occasional (HP:0040283). (ORPHA:96061)
- Short stature (HP:0004322): A height below that which is expected according to age and gender norms. Although there is no universally accepted definition of short stature, many refer to "short stature" as height more than 2 standard deviations below the mean for age and gender (or below the 3rd percentile for age and gender dependent norms). Evidence: TAS. Frequency: Occasional (HP:0040283). (ORPHA:96061)
- Decreased testicular size (HP:0008734): Reduced volume of the testicle (the male gonad). Evidence: TAS. Frequency: Occasional (HP:0040283). (ORPHA:96061)
- Abnormal cardiovascular system morphology (HP:0030680): Any structural anomaly of the heart and blood vessels. Evidence: TAS. Frequency: Occasional (HP:0040283). (ORPHA:96061)
These phenotypes are associated with the disease Mosaic trisomy 8 syndrome (ORPHA:96061).